Phenotypes associated with the disease vestibulocochlear dysfunction, progressive (OMIM:193005):
- Abnormality of the nervous system (HP:0000707): An abnormality of the nervous system. Evidence: IEA. (OMIM:193005)
- Tinnitus (HP:0000360): Tinnitus is an auditory perception that can be described as the experience of sound, in the ear or in the head, in the absence of external acoustic stimulation. Evidence: IEA. (OMIM:193005)
- Progressive hearing impairment (HP:0001730): A progressive form of hearing impairment. Evidence: IEA. (OMIM:193005)
- Vestibular areflexia (HP:0008568): Vestibular areflexia can be measured as the absence of the caloric nystagmus response in electronystagmography. Evidence: IEA. (OMIM:193005)
- Autosomal dominant inheritance (HP:0000006): A mode of inheritance that is observed for traits related to a gene encoded on one of the autosomes (i.e., the human chromosomes 1-22) in which a trait manifests in heterozygotes. In the context of medical genetics, an autosomal dominant disorder is caused when a single copy of the mutant allele is present. Males and females are affected equally, and can both transmit the disorder with a risk of 50% for each child of inheriting the mutant allele. Evidence: IEA. (OMIM:193005)